Phenotypes associated with the disease atrial fibrillation, familial, 5 (OMIM:611494):
- Atrial fibrillation (HP:0005110): An atrial arrhythmia characterized by disorganized atrial activity without discrete P waves on the surface EKG, but instead by an undulating baseline or more sharply circumscribed atrial deflections of varying amplitude an frequency ranging from 350 to 600 per minute. Evidence: PCS. (PMID:17603472)
- Polygenic inheritance (HP:0010982): A mode of inheritance that depends on a mixture of major and minor genetic determinants possibly together with environmental factors. Diseases inherited in this manner are termed complex diseases. Evidence: PCS. (PMID:17603472)